- Rhinorrhea (HP:0031417): Increased discharge of mucus from the nose. Evidence: IEA. (OMIM:167400)
- Bradycardia (HP:0001662): A slower than normal heart rate (in adults, slower than 60 beats per minute). Evidence: IEA. (OMIM:167400)
- Flushing (HP:0031284): Recurrent episodes of redness of the skin together with a sensation of warmth or burning of the affected areas of skin. Evidence: PCS. (PMID:17145499)
- Ocular pain (HP:0200026): An unpleasant sensation characterized by physical discomfort (such as pricking, throbbing, or aching) localized to the eye. Evidence: PCS. (PMID:17145499)
- Anal pain (HP:0500005): Pain in and around the anus or rectum (perianal region). Evidence: PCS. (PMID:17145499)
- Mandibular pain (HP:0200025): An unpleasant sensation characterized by physical discomfort (such as pricking, throbbing, or aching) localized to the mandible. Evidence: PCS. (PMID:17145499)
- Tachycardia (HP:0001649): A rapid heartrate that exceeds the range of the normal resting heartrate for age. Evidence: IEA. (OMIM:167400)
- Autosomal dominant inheritance (HP:0000006): A mode of inheritance that is observed for traits related to a gene encoded on one of the autosomes (i.e., the human chromosomes 1-22) in which a trait manifests in heterozygotes. In the context of medical genetics, an autosomal dominant disorder is caused when a single copy of the mutant allele is present. Males and females are affected equally, and can both transmit the disorder with a risk of 50% for each child of inheriting the mutant allele. Evidence: PCS. (PMID:17145499)
- Lacrimation abnormality (HP:0000632): Abnormality of tear production. Evidence: IEA. (OMIM:167400)
- Impaired pain sensation (HP:0007328): Reduced ability to perceive painful stimuli. Evidence: IEA. (OMIM:167400)
- Neonatal onset (HP:0003623): Onset of signs or symptoms of disease within the first 28 days of life. Evidence: PCS. (PMID:17145499)
These phenotypes are associated with the disease paroxysmal extreme pain disorder (OMIM:167400).